Phenotypes associated with the disease retinal dystrophy with leukodystrophy (OMIM:618863):
- Progressive microcephaly (HP:0000253): Progressive microcephaly is diagnosed when the head circumference falls progressively behind age- and gender-dependent norms. Evidence: PCS. Frequency: 1/1. (PMID:27799409)
- Prominent ear helix (HP:0009904): Abnormally prominent ear helix. Evidence: PCS. Frequency: 1/1. (PMID:27799409)
- Cleft palate (HP:0000175): Cleft palate is a developmental defect of the palate resulting from a failure of fusion of the palatine processes and manifesting as a separation of the roof of the mouth (soft and hard palate). Evidence: PCS. Frequency: 1/1. (PMID:27799409)
- Rotary nystagmus (HP:0001583): A form of nystagmus in which the eyeball makes rotary motions around the axis. Evidence: PCS. Frequency: 1/1. (PMID:27799409)
- Delayed speech and language development (HP:0000750): A degree of language development that is significantly below the norm for a child of a specified age. Evidence: PCS. Frequency: 1/1. (PMID:27799409)
- Truncal titubation (HP:0030147): Tremor of the trunk in an anterior-posterior plane at 3-4 Hz. Evidence: PCS. Frequency: 1/1. (PMID:27799409)
- Dysmetria (HP:0001310): A type of ataxia characterized by the inability to carry out movements with the correct range and motion across the plane of more than one joint related to incorrect estimation of the distances required for targeted movements. Evidence: PCS. Frequency: 1/1. (PMID:27799409)
- Dysarthria (HP:0001260): Dysarthric speech is a general description referring to a neurological speech disorder characterized by poor articulation. Depending on the involved neurological structures, dysarthria may be further classified as spastic, flaccid, ataxic, hyperkinetic and hypokinetic, or mixed. Evidence: PCS. Frequency: 1/1. (PMID:27799409)
- Motor delay (HP:0001270): A type of Developmental delay characterized by a delay in acquiring motor skills. Evidence: PCS. Frequency: 1/1. (PMID:27799409)
- Gowers sign (HP:0003391): A phenomenon whereby patients are not able to stand up without the use of the hands owing to weakness of the proximal muscles of the lower limbs. Evidence: PCS. Frequency: 1/1. (PMID:27799409)
- Very long chain fatty acid accumulation (HP:0008167). Evidence: PCS. Frequency: 1/1. (PMID:27799409)
- Autosomal recessive inheritance (HP:0000007): A mode of inheritance that is observed for traits related to a gene encoded on one of the autosomes (i.e., the human chromosomes 1-22) in which a trait manifests in individuals with two pathogenic alleles, either homozygotes (two copies of the same mutant allele) or compound heterozygotes (whereby each copy of a gene has a distinct mutant allele). Evidence: PCS. (PMID:27799409)
- Hypotelorism (HP:0000601): Interpupillary distance less than 2 SD below the mean (alternatively, the appearance of an decreased interpupillary distance or closely spaced eyes). Evidence: PCS. Frequency: 1/1. (PMID:27799409)
- Waddling gait (HP:0002515): Weakness of the hip girdle and upper thigh muscles, for instance in myopathies, leads to an instability of the pelvis on standing and walking. If the muscles extending the hip joint are affected, the posture in that joint becomes flexed and lumbar lordosis increases. The patients usually have difficulties standing up from a sitting position. Due to weakness in the gluteus medius muscle, the hip on the side of the swinging leg drops with each step (referred to as Trendelenburg sign). The gait appears waddling. The patients frequently attempt to counteract the dropping of the hip on the swinging side by bending the trunk towards the side which is in the stance phase (in the German language literature this is referred to as Duchenne sign). Similar gait patterns can be caused by orthopedic conditions when the origin and the insertion site of the gluteus medius muscle are closer to each other than normal, for instance due to a posttraumatic elevation of the trochanter or pseudarthrosis of the femoral neck. Evidence: PCS. Frequency: 1/1. (PMID:27799409)
- CNS hypomyelination (HP:0003429): Reduced amount of myelin in the central nervous system resulting from defective myelinogenesis. Evidence: PCS. Frequency: 1/1. (PMID:27799409)
- Falls (HP:0002527). Evidence: PCS. Frequency: 1/1. (PMID:27799409)
- Proximal muscle weakness (HP:0003701): A lack of strength of the proximal muscles. Evidence: PCS. Frequency: 1/1. (PMID:27799409)
- Rod-cone dystrophy (HP:0000510): An inherited retinal disease subtype in which the rod photoreceptors appear to be more severely affected than the cone photoreceptors. Typical presentation is with nyctalopia (due to rod dysfunction) followed by loss of mid-peripheral field of vision, which gradually extends and leaves many patients with a small central island of vision due to the preservation of macular cones. Evidence: PCS. Frequency: 1/1. (PMID:27799409)
- Bilateral ptosis (HP:0001488). Evidence: PCS. Frequency: 1/1. (PMID:27799409)